- Tracheoesophageal fistula (HP:0002575): An abnormal connection (fistula) between the esophagus and the trachea. Evidence: IEA. (OMIM:189960)
- Esophageal atresia (HP:0002032): A developmental defect resulting in complete obliteration of the lumen of the esophagus such that the esophagus ends in a blind pouch rather than connecting to the stomach. Evidence: IEA. (OMIM:189960)
These phenotypes are associated with the disease esophageal atresia/tracheoesophageal fistula (OMIM:189960).